Phenotypes associated with the disease Brachydactyly type E (ORPHA:93387):
- Macrocephaly (HP:0000256): Occipitofrontal (head) circumference greater than 97th centile compared to appropriate, age matched, sex-matched normal standards. Alternatively, a apparently increased size of the cranium. Evidence: TAS. Frequency: Occasional (HP:0040283). (ORPHA:93387)
- Frontal bossing (HP:0002007): Bilateral bulging of the lateral frontal bone prominences with relative sparing of the midline. Evidence: TAS. Frequency: Occasional (HP:0040283). (ORPHA:93387)
- Short stature (HP:0004322): A height below that which is expected according to age and gender norms. Although there is no universally accepted definition of short stature, many refer to "short stature" as height more than 2 standard deviations below the mean for age and gender (or below the 3rd percentile for age and gender dependent norms). Evidence: TAS. Frequency: Frequent (HP:0040282). (ORPHA:93387)
- Type E brachydactyly (HP:0005863): In type E brachydactyly, shortening of the fingers is mainly in the metacarpals and metatarsals. Evidence: TAS. Frequency: Very frequent (HP:0040281). (ORPHA:93387)
- Short distal phalanx of finger (HP:0009882): Short distance from the end of the finger to the most distal interphalangeal crease or the distal interphalangeal joint flexion point. That is, hypoplasia of one or more of the distal phalanx of finger. Evidence: TAS. Frequency: Frequent (HP:0040282). (ORPHA:93387)
- Short metacarpal (HP:0010049): Diminished length of one or more metacarpal bones in relation to the others of the same hand or to the contralateral metacarpal. Evidence: TAS. Frequency: Very frequent (HP:0040281). (ORPHA:93387)
- Aplasia/Hypoplasia of the distal phalanx of the hallux (HP:0010076). Evidence: TAS. Frequency: Occasional (HP:0040283). (ORPHA:93387)
- Short metatarsal (HP:0010743): Diminished length of a metatarsal bone, with resultant proximal displacement of the associated toe. Evidence: TAS. Frequency: Occasional (HP:0040283). (ORPHA:93387)
- Upper limb asymmetry (HP:0100560): Difference in length or size between the right and left arm. Evidence: TAS. Frequency: Occasional (HP:0040283). (ORPHA:93387)
- Joint hypermobility (HP:0001382): The capability that a joint (or a group of joints) has to move, passively and/or actively, beyond normal limits along physiological axes. Evidence: TAS. Frequency: Frequent (HP:0040282). (ORPHA:93387)